- Seizure (HP:0001250): A seizure is an intermittent abnormality of nervous system physiology characterized by a transient occurrence of signs and/or symptoms due to abnormal excessive or synchronous neuronal activity in the brain. Evidence: IEA. (OMIM:222350)
- Hyperlysinuria (HP:0003297): An increased concentration of lysine in the urine. Evidence: IEA. (OMIM:222350)
- Ataxia (HP:0001251): Ataxia refers to impaired coordination of voluntary muscle movement. Cerebellar ataxia refers to ataxia due to dysfunction of the cerebellum. This causes a variety of elementary neurological deficits including asynergy (lack of coordination between muscles, limbs and joints), dysmetria (lack of ability to judge distances that can lead to under- or overshoot in grasping movements), and dysdiadochokinesia (inability to perform rapid movements requiring antagonizing muscle groups to be switched on and off repeatedly). Evidence: IEA. (OMIM:222350)
- Cystinuria (HP:0003131): An increased concentration of cystine in the urine. Evidence: IEA. (OMIM:222350)
- Autosomal recessive inheritance (HP:0000007): A mode of inheritance that is observed for traits related to a gene encoded on one of the autosomes (i.e., the human chromosomes 1-22) in which a trait manifests in individuals with two pathogenic alleles, either homozygotes (two copies of the same mutant allele) or compound heterozygotes (whereby each copy of a gene has a distinct mutant allele). Evidence: IEA. (OMIM:222350)
- Neurodegeneration (HP:0002180): Progressive loss of neural cells and tissue. Evidence: IEA. (OMIM:222350)
- Spasticity (HP:0001257): A motor disorder characterized by a velocity-dependent increase in tonic stretch reflexes with increased muscle tone, exaggerated (hyperexcitable) tendon reflexes. Evidence: IEA. (OMIM:222350)
These phenotypes are associated with the disease diaminopentanuria (OMIM:222350).